- Lymphedema (HP:0001004): Localized fluid retention and tissue swelling caused by a compromised lymphatic system. Evidence: TAS. Frequency: Very frequent (HP:0040281). (ORPHA:90186)
- Atypical scarring of skin (HP:0000987): Atypically scarred skin . Evidence: TAS. Frequency: Frequent (HP:0040282). (ORPHA:90186)
- Recurrent skin infections (HP:0001581): Infections of the skin that happen multiple times. Evidence: TAS. Frequency: Frequent (HP:0040282). (ORPHA:90186)
- Lymph node hypoplasia (HP:0002732): Underdevelopment of the lymph nodes. Evidence: TAS. Frequency: Frequent (HP:0040282). (ORPHA:90186)
- Absence of lymph node germinal center (HP:0002849): Absence of germinal centers in lymph nodes. Germinal centers are the parts of lymph nodes in which B lymphocytes proliferate, differentiate, mutate through somatic hypermutation and class switch during antibody responses. Evidence: TAS. Frequency: Frequent (HP:0040282). (ORPHA:90186)
- Predominantly lower limb lymphedema (HP:0003550): Localized fluid retention and tissue swelling caused by a compromised lymphatic system, affecting mainly the legs. Evidence: TAS. Frequency: Frequent (HP:0040282). (ORPHA:90186)
- Recurrent bacterial skin infections (HP:0005406): Increased susceptibility to bacterial infections of the skin, as manifested by recurrent episodes of infectious dermatitis. Evidence: TAS. Frequency: Frequent (HP:0040282). (ORPHA:90186)
- Pedal edema (HP:0010741): An abnormal accumulation of excess fluid in the lower extremity resulting in swelling of the feet and extending upward to the lower leg. Evidence: TAS. Frequency: Frequent (HP:0040282). (ORPHA:90186)
- Skin dimple (HP:0010781): Skin dimples are cutaneous indentations that are the result of tethering of the skin to underlying structures (bone) causing an indentation. Evidence: TAS. Frequency: Frequent (HP:0040282). (ORPHA:90186)
- Cobblestone-like hyperkeratosis (HP:0031288): The presence of verrucous, cobblestone-like papules and nodules in a region of skin that is said to have an appearance like that of cobblestones. Evidence: TAS. Frequency: Frequent (HP:0040282). (ORPHA:90186)
- Cellulitis (HP:0100658): A bacterial infection and inflammation of the skin und subcutaneous tissues. Evidence: TAS. Frequency: Frequent (HP:0040282). (ORPHA:90186)
- Skin erosion (HP:0200041): A discontinuity of the skin exhibiting incomplete loss of the epidermis, a lesion that is moist, circumscribed, and usually depressed. Evidence: TAS. Frequency: Frequent (HP:0040282). (ORPHA:90186)
- Facial edema (HP:0000282). Evidence: TAS. Frequency: Occasional (HP:0040283). (ORPHA:90186)
- Pleural effusion (HP:0002202): The presence of an excessive amount of fluid in the pleural cavity. Evidence: TAS. Frequency: Occasional (HP:0040283). (ORPHA:90186)
- Varicose veins (HP:0002619): Enlarged and tortuous veins. Evidence: TAS. Frequency: Occasional (HP:0040283). (ORPHA:90186)
- Edema of the dorsum of hands (HP:0007514): An abnormal accumulation of fluid beneath the skin on the back of the hands. Evidence: TAS. Frequency: Occasional (HP:0040283). (ORPHA:90186)
- Laryngeal edema (HP:0012027): An abnormal accumulation of fluid and swelling in the tissues of the larynx. Evidence: TAS. Frequency: Occasional (HP:0040283). (ORPHA:90186)
- Peripheral edema (HP:0012398): An abnormal accumulation of interstitial fluid in the soft tissues of the limbs. Evidence: TAS. Frequency: Occasional (HP:0040283). (ORPHA:90186)
- Periorbital edema (HP:0100539): Edema affecting the region situated around the orbit of the eye. Evidence: TAS. Frequency: Occasional (HP:0040283). (ORPHA:90186)
- Skin ulcer (HP:0200042): A discontinuity of the skin exhibiting complete loss of the epidermis and often portions of the dermis and even subcutaneous fat. Evidence: TAS. Frequency: Occasional (HP:0040283). (ORPHA:90186)
- Angiosarcoma (HP:0200058). Evidence: TAS. Frequency: Occasional (HP:0040283). (ORPHA:90186)
These phenotypes are associated with the disease Meige disease (ORPHA:90186).